- Abnormality of the ureter (HP:0000069): An abnormality of the ureter. The ureter is the duct by which urine passes from the kidney to the bladder. Evidence: TAS. Frequency: Very frequent (HP:0040281). (ORPHA:1770)
- Gonadal dysgenesis (HP:0000133): Gonadal dysgenesis is the name given to any of a multitude of conditions that can cause impaired development of the gonads, i.e., the testes or ovaries, or to the related phenotypic features. The term is to be avoided if possible for new annotations, and more specific terms should be chosen. Evidence: TAS. Frequency: Very frequent (HP:0040281). (ORPHA:1770)
- Polycystic ovaries (HP:0000147). Evidence: TAS. Frequency: Very frequent (HP:0040281). (ORPHA:1770)
- Atresia of the external auditory canal (HP:0000413): Absence or failure to form of the external auditory canal. Evidence: TAS. Frequency: Very frequent (HP:0040281). (ORPHA:1770)
- Brachydactyly (HP:0001156): Digits that appear disproportionately short compared to the hand/foot. The word brachydactyly is used here to describe a series distinct patterns of shortened digits (brachydactyly types A-E). This is the sense used here. Evidence: TAS. Frequency: Very frequent (HP:0040281). (ORPHA:1770)
- Large hands (HP:0001176). Evidence: TAS. Frequency: Very frequent (HP:0040281). (ORPHA:1770)
- Mild intellectual disability (HP:0001256): Mild intellectual disability (ID) is defined as a type of ID characterized by mildly sub-average adaptive functioning and intellectual functioning, with an intelligence quotient (IQ) the range of 50-69. Evidence: TAS. Frequency: Very frequent (HP:0040281). (ORPHA:1770)
- Umbilical hernia (HP:0001537): Protrusion of abdominal contents through a defect in the abdominal wall musculature around the umbilicus. Skin and subcutaneous tissue overlie the defect. Evidence: TAS. Frequency: Very frequent (HP:0040281). (ORPHA:1770)
- Ventricular septal defect (HP:0001629): A hole between the two bottom chambers (ventricles) of the heart. The defect is centered around the most superior aspect of the ventricular septum. Evidence: TAS. Frequency: Very frequent (HP:0040281). (ORPHA:1770)
- Delayed skeletal maturation (HP:0002750): A decreased rate of skeletal maturation. Delayed skeletal maturation can be diagnosed on the basis of an estimation of the bone age from radiographs of specific bones in the human body. Evidence: TAS. Frequency: Very frequent (HP:0040281). (ORPHA:1770)
- Biparietal narrowing (HP:0004422): A narrowing of the biparietal diameter (i.e., of the transverse distance between the protuberances of the two parietal bones of the skull). Evidence: TAS. Frequency: Very frequent (HP:0040281). (ORPHA:1770)
- Preauricular pit (HP:0004467): Small indentation anterior to the insertion of the ear. Evidence: TAS. Frequency: Very frequent (HP:0040281). (ORPHA:1770)
- Bilateral single transverse palmar creases (HP:0007598): The distal and proximal transverse palmar creases are merged into a single transverse palmar crease on both hands. Evidence: TAS. Frequency: Very frequent (HP:0040281). (ORPHA:1770)
- Abnormal hair pattern (HP:0010720): An abnormality of the distribution of hair growth. Evidence: TAS. Frequency: Very frequent (HP:0040281). (ORPHA:1770)
- Broad thumb (HP:0011304): Increased thumb width without increased dorso-ventral dimension. Evidence: TAS. Frequency: Very frequent (HP:0040281). (ORPHA:1770)
- Mild global developmental delay (HP:0011342): A mild delay in the achievement of motor or mental milestones in the domains of development of a child. Evidence: TAS. Frequency: Very frequent (HP:0040281). (ORPHA:1770)
- Cleft palate (HP:0000175): Cleft palate is a developmental defect of the palate resulting from a failure of fusion of the palatine processes and manifesting as a separation of the roof of the mouth (soft and hard palate). Evidence: TAS. Frequency: Frequent (HP:0040282). (ORPHA:1770)
- Epicanthus (HP:0000286): A fold of skin starting above the medial aspect of the upper eyelid and arching downward to cover, pass in front of and lateral to the medial canthus. Evidence: TAS. Frequency: Frequent (HP:0040282). (ORPHA:1770)
- Abnormality of the philtrum (HP:0000288): An abnormality of the philtrum. Evidence: TAS. Frequency: Frequent (HP:0040282). (ORPHA:1770)
- Downslanted palpebral fissures (HP:0000494): The palpebral fissure inclination is more than two standard deviations below the mean. Evidence: TAS. Frequency: Frequent (HP:0040282). (ORPHA:1770)
- Short columella (HP:0002000): Reduced distance from the anterior border of the naris to the subnasale. Evidence: TAS. Frequency: Frequent (HP:0040282). (ORPHA:1770)
- Short stature (HP:0004322): A height below that which is expected according to age and gender norms. Although there is no universally accepted definition of short stature, many refer to "short stature" as height more than 2 standard deviations below the mean for age and gender (or below the 3rd percentile for age and gender dependent norms). Evidence: TAS. Frequency: Frequent (HP:0040282). (ORPHA:1770)
- Microtia (HP:0008551): Underdevelopment of the external ear. Evidence: TAS. Frequency: Frequent (HP:0040282). (ORPHA:1770)
- Renal hypoplasia/aplasia (HP:0008678): Absence or underdevelopment of the kidney. Evidence: TAS. Frequency: Frequent (HP:0040282). (ORPHA:1770)
- Non-midline cleft of the upper lip (HP:0100335): Clefting (gap or groove) of the upper lip affecting the lateral portions of the upper lip rather than the midline/median region. Evidence: TAS. Frequency: Frequent (HP:0040282). (ORPHA:1770)
- Posteriorly rotated ears (HP:0000358): A type of abnormal location of the ears in which the position of the ears is characterized by posterior rotation (the superior part of the ears is rotated towards the back of the head, and the inferior part of the ears towards the front). Evidence: TAS. Frequency: Frequent (HP:0040282). (ORPHA:1770)
These phenotypes are associated with the disease XY type gonadal dysgenesis-associated anomalies syndrome (ORPHA:1770).